Phenotypes associated with the disease mitochondrial complex I deficiency, nuclear type 10 (OMIM:618233):
- Encephalopathy (HP:0001298): Encephalopathy is a term that means brain disease, damage, or malfunction. In general, encephalopathy is manifested by an altered mental state. Evidence: IEA. (OMIM:618233)
- Progressive (HP:0003676): Applies to a disease manifestation that increases in scope or severity over the course of time, i.e., that worsens with age. Evidence: PCS. (PMID:16200211)
- Dysmetria (HP:0001310): A type of ataxia characterized by the inability to carry out movements with the correct range and motion across the plane of more than one joint related to incorrect estimation of the distances required for targeted movements. Evidence: IEA. (OMIM:618233)
- Seizure (HP:0001250): A seizure is an intermittent abnormality of nervous system physiology characterized by a transient occurrence of signs and/or symptoms due to abnormal excessive or synchronous neuronal activity in the brain. Evidence: IEA. Frequency: Very rare (HP:0040284). (OMIM:618233)
- Hypotonia (HP:0001252): Hypotonia is an abnormally low muscle tone (the amount of tension or resistance to movement in a muscle). Even when relaxed, muscles have a continuous and passive partial contraction which provides some resistance to passive stretching. Hypotonia thus manifests as diminished resistance to passive stretching. Hypotonia is not the same as muscle weakness, although the two conditions can co-exist. Evidence: PCS. Frequency: 1/1. (PMID:16200211)
- Ataxia (HP:0001251): Ataxia refers to impaired coordination of voluntary muscle movement. Cerebellar ataxia refers to ataxia due to dysfunction of the cerebellum. This causes a variety of elementary neurological deficits including asynergy (lack of coordination between muscles, limbs and joints), dysmetria (lack of ability to judge distances that can lead to under- or overshoot in grasping movements), and dysdiadochokinesia (inability to perform rapid movements requiring antagonizing muscle groups to be switched on and off repeatedly). Evidence: PCS. Frequency: 1/1. (PMID:16200211)
- Nystagmus (HP:0000639): Rhythmic, involuntary oscillations of one or both eyes related to abnormality in fixation, conjugate gaze, or vestibular mechanisms. Evidence: PCS. Frequency: 1/1. (PMID:16200211)
- Childhood onset (HP:0011463): Onset of disease at the age of between 1 and 5 years. Evidence: PCS. Frequency: 1/1. (PMID:16200211)
- Respiratory failure (HP:0002878): A severe form of respiratory insufficiency characterized by inadequate gas exchange such that the levels of oxygen or carbon dioxide cannot be maintained within normal limits. Evidence: PCS. Frequency: 1/1. (PMID:16200211)
- Hyporeflexia (HP:0001265): Reduction of neurologic reflexes such as the knee-jerk reaction. Evidence: PCS. Frequency: 1/1. (PMID:16200211)
- Broad-based gait (HP:0002136): An abnormal gait pattern in which persons stand and walk with their feet spaced widely apart. This is often a component of cerebellar ataxia. Evidence: PCS. Frequency: 1/1. (PMID:16200211)
- Dysphagia (HP:0002015): Difficulty in swallowing. Evidence: PCS. Frequency: 1/1. (PMID:16200211)
- Feeding difficulties (HP:0011968): Impaired ability to eat related to problems gathering food and getting ready to suck, chew, or swallow it. Evidence: PCS. Frequency: 1/1. (PMID:16200211)
- Leukoencephalopathy (HP:0002352): This term describes abnormality of the white matter of the cerebrum resulting from damage to the myelin sheaths of nerve cells. Evidence: IEA. (OMIM:618233)
- Global developmental delay (HP:0001263): A delay in the achievement of motor or mental milestones in the domains of development of a child, including motor skills, speech and language, cognitive skills, and social and emotional skills. This term should only be used to describe children younger than five years of age. Evidence: PCS. Frequency: 1/1. (PMID:16200211)
- Areflexia (HP:0001284): Absence of neurologic reflexes such as the knee-jerk reaction. Evidence: PCS. Frequency: 1/1. (PMID:16200211)
- Increased CSF lactate (HP:0002490): Increased concentration of lactate in the cerebrospinal fluid. Evidence: PCS. Frequency: 1/1. (PMID:16200211)
- Decreased activity of mitochondrial complex I (HP:0011923): A reduction in the activity of the mitochondrial respiratory chain complex I, which is part of the electron transport chain in mitochondria. Evidence: PCS. Frequency: 1/1. (PMID:16200211)
- Sleep apnea (HP:0010535): An intermittent cessation of airflow at the mouth and nose during sleep is known as sleep apnea. Apneas that last at least 10 seconds are considered significant, but individuals with sleep apnea may experience apneas lasting from 20 seconds up to 2 or 3 minutes. Patients may have up to 15 events per hour of sleep. Evidence: PCS. Frequency: 1/1. (PMID:16200211)
- Central hypoventilation (HP:0007110). Evidence: IEA. (OMIM:618233)
- Autosomal recessive inheritance (HP:0000007): A mode of inheritance that is observed for traits related to a gene encoded on one of the autosomes (i.e., the human chromosomes 1-22) in which a trait manifests in individuals with two pathogenic alleles, either homozygotes (two copies of the same mutant allele) or compound heterozygotes (whereby each copy of a gene has a distinct mutant allele). Evidence: PCS. (PMID:16200211)
- Optic atrophy (HP:0000648): Atrophy of the optic nerve. Optic atrophy results from the death of the retinal ganglion cell axons that comprise the optic nerve and manifesting as a pale optic nerve on fundoscopy. Evidence: PCS. Frequency: 1/1. (PMID:16200211)
- Apnea (HP:0002104): Lack of breathing with no movement of the respiratory muscles and no exchange of air in the lungs. This term refers to a disposition to have recurrent episodes of apnea rather than to a single event. Evidence: IEA. (OMIM:618233)
- Horizontal nystagmus (HP:0000666): Nystagmus consisting of horizontal to-and-fro eye movements. Evidence: PCS. Frequency: 1/1. (PMID:16200211)
- External ophthalmoplegia (HP:0000544): Paralysis of the external ocular muscles. Evidence: IEA. Frequency: Very rare (HP:0040284). (OMIM:618233)